Phenotypes associated with the disease vitiligo-associated multiple autoimmune disease susceptibility 1 (OMIM:606579):
- Vitiligo (HP:0001045). Evidence: PCS. (PMID:20526340)
- Polygenic inheritance (HP:0010982): A mode of inheritance that depends on a mixture of major and minor genetic determinants possibly together with environmental factors. Diseases inherited in this manner are termed complex diseases. Evidence: PCS. (PMID:20526340)